- Depression (HP:0000716): Frequently experiencing feelings of being down, miserable, and/or hopeless; struggling to recover from these moods; having a pessimistic outlook on the future; feeling a pervasive sense of shame; having a low self-worth; experiencing thoughts of suicide and engaging in suicidal behavior. Evidence: TAS. (OMIM:608516)
- Polygenic inheritance (HP:0010982): A mode of inheritance that depends on a mixture of major and minor genetic determinants possibly together with environmental factors. Diseases inherited in this manner are termed complex diseases. Evidence: TAS. (OMIM:608516)
These phenotypes are associated with the disease major depressive disorder (OMIM:608516).